- Posteriorly rotated ears (HP:0000358): A type of abnormal location of the ears in which the position of the ears is characterized by posterior rotation (the superior part of the ears is rotated towards the back of the head, and the inferior part of the ears towards the front). Evidence: TAS. Frequency: Very frequent (HP:0040281). (ORPHA:3376)
- Intrauterine growth retardation (HP:0001511): An abnormal restriction of fetal growth with fetal weight below the tenth percentile for gestational age. Evidence: TAS. Frequency: Very frequent (HP:0040281). (ORPHA:3376)
- Abnormality of chromosome segregation (HP:0002916): An abnormality of chromosome segregation. Evidence: TAS. Frequency: Very frequent (HP:0040281). (ORPHA:3376)
- Decreased skull ossification (HP:0004331): A reduction in the magnitude or amount of ossification of the skull. Evidence: TAS. Frequency: Very frequent (HP:0040281). (ORPHA:3376)
- Hypoplasia of penis (HP:0008736). Evidence: TAS. Frequency: Very frequent (HP:0040281). (ORPHA:3376)
- Macroglossia (HP:0000158): Increased length and width of the tongue. Evidence: TAS. Frequency: Frequent (HP:0040282). (ORPHA:3376)
- Cleft palate (HP:0000175): Cleft palate is a developmental defect of the palate resulting from a failure of fusion of the palatine processes and manifesting as a separation of the roof of the mouth (soft and hard palate). Evidence: TAS. Frequency: Frequent (HP:0040282). (ORPHA:3376)
- Micrognathia (HP:0000347): Developmental hypoplasia of the mandible. Evidence: TAS. Frequency: Frequent (HP:0040282). (ORPHA:3376)
- Cataract (HP:0000518): A cataract is an opacity or clouding that develops in the crystalline lens of the eye or in its capsule. Evidence: TAS. Frequency: Frequent (HP:0040282). (ORPHA:3376)
- Iris coloboma (HP:0000612): A coloboma of the iris. Evidence: TAS. Frequency: Frequent (HP:0040282). (ORPHA:3376)
- Narrow chest (HP:0000774): Reduced width of the chest from side to side, associated with a reduced distance from the sternal notch to the tip of the shoulder. Evidence: TAS. Frequency: Frequent (HP:0040282). (ORPHA:3376)
- Omphalocele (HP:0001539): A midline anterior incomplete closure of the abdominal wall in which there is herniation of the abdominal viscera into the base of the abdominal cord. Evidence: TAS. Frequency: Frequent (HP:0040282). (ORPHA:3376)
- Polyhydramnios (HP:0001561): The presence of excess amniotic fluid in the uterus during pregnancy. Evidence: TAS. Frequency: Frequent (HP:0040282). (ORPHA:3376)
- Hepatomegaly (HP:0002240): Abnormally increased size of the liver. Evidence: TAS. Frequency: Frequent (HP:0040282). (ORPHA:3376)
- Finger syndactyly (HP:0006101): Webbing or fusion of the fingers, involving soft parts only or including bone structure. Bony fusions are referred to as "bony" Syndactyly if the fusion occurs in a radio-ulnar axis. Fusions of bones of the fingers in a proximo-distal axis are referred to as "Symphalangism". Evidence: TAS. Frequency: Frequent (HP:0040282). (ORPHA:3376)
- Aplasia/Hypoplasia affecting the eye (HP:0008056). Evidence: TAS. Frequency: Frequent (HP:0040282). (ORPHA:3376)
- Non-midline cleft of the upper lip (HP:0100335): Clefting (gap or groove) of the upper lip affecting the lateral portions of the upper lip rather than the midline/median region. Evidence: TAS. Frequency: Frequent (HP:0040282). (ORPHA:3376)
- Ambiguous genitalia (HP:0000062): A genital phenotype that is not clearly assignable to a single gender. Ambiguous genitalia can be evaluated using the Prader scale: Prader 0: Normal female external genitalia. Prader 1: Female external genitalia with clitoromegaly. Prader 2: Clitoromegaly with partial labial fusion forming a funnel-shaped urogenital sinus. Prader 3: Increased phallic enlargement. Complete labioscrotal fusion forming a urogenital sinus with a single opening. Prader 4: Complete scrotal fusion with urogenital opening at the base or on the shaft of the phallus. Prader 5: Normal male external genitalia. The diagnosis of ambiguous genitalia is made for Prader 1-4. Evidence: TAS. Frequency: Occasional (HP:0040283). (ORPHA:3376)
- Narrow mouth (HP:0000160): Distance between the commissures of the mouth more than 2 SD below the mean. Alternatively, an apparently decreased width of the oral aperture (subjective). Evidence: TAS. Frequency: Occasional (HP:0040283). (ORPHA:3376)
- Hydrocephalus (HP:0000238): Hydrocephalus is an active distension of the ventricular system of the brain resulting from inadequate passage of CSF from its point of production within the cerebral ventricles to its point of absorption into the systemic circulation. Evidence: TAS. Frequency: Occasional (HP:0040283). (ORPHA:3376)
- Macrocephaly (HP:0000256): Occipitofrontal (head) circumference greater than 97th centile compared to appropriate, age matched, sex-matched normal standards. Alternatively, a apparently increased size of the cranium. Evidence: TAS. Frequency: Occasional (HP:0040283). (ORPHA:3376)
- Short neck (HP:0000470): Diminished length of the neck. Evidence: TAS. Frequency: Occasional (HP:0040283). (ORPHA:3376)
- Holoprosencephaly (HP:0001360): Holoprosencephaly is a structural anomaly of the brain in which the developing forebrain fails to divide into two separate hemispheres and ventricles. Evidence: TAS. Frequency: Occasional (HP:0040283). (ORPHA:3376)
- Abnormal cardiac septum morphology (HP:0001671): An anomaly of the intra-atrial or intraventricular septum. Evidence: TAS. Frequency: Occasional (HP:0040283). (ORPHA:3376)
- Abnormality of the pancreas (HP:0001732): An abnormality of the pancreas. Evidence: TAS. Frequency: Occasional (HP:0040283). (ORPHA:3376)
- Meningocele (HP:0002435): Protrusion of the meninges through a defect of the skull or vertebral column. Evidence: TAS. Frequency: Occasional (HP:0040283). (ORPHA:3376)
- Intestinal malrotation (HP:0002566): An abnormality of the intestinal rotation and fixation that normally occurs during the development of the gut. This can lead to volvulus, or twisting of the intestine that causes obstruction and necrosis. Evidence: TAS. Frequency: Occasional (HP:0040283). (ORPHA:3376)
- Abnormality of the gallbladder (HP:0005264): An abnormality of the gallbladder. Evidence: TAS. Frequency: Occasional (HP:0040283). (ORPHA:3376)
- Aplasia/Hypoplasia of the corpus callosum (HP:0007370): Absence or underdevelopment of the corpus callosum. Evidence: TAS. Frequency: Occasional (HP:0040283). (ORPHA:3376)
- Cryptorchidism (HP:0000028): Testis in inguinal canal. That is, absence of one or both testes from the scrotum owing to failure of the testis or testes to descend through the inguinal canal to the scrotum. Evidence: TAS. Frequency: Very frequent (HP:0040281). (ORPHA:3376)
- Hypospadias (HP:0000047): Abnormal position of urethral meatus on the ventral penile shaft (underside) characterized by displacement of the urethral meatus from the tip of the glans penis to the ventral surface of the penis, scrotum, or perineum. Evidence: TAS. Frequency: Very frequent (HP:0040281). (ORPHA:3376)
- Wide mouth (HP:0000154): Distance between the oral commissures more than 2 SD above the mean. Alternatively, an apparently increased width of the oral aperture (subjective). Evidence: TAS. Frequency: Very frequent (HP:0040281). (ORPHA:3376)
- Abnormal cranial suture/fontanelle morphology (HP:0000235): Any abnormality of the fontanelles (the regions covered by a thick membrane that normally ossify in the first two years of life) or the cranial sutures (the fibrous joints in which the articulating bones or cartilages of the skull are connected by sutural ligaments). Evidence: TAS. Frequency: Very frequent (HP:0040281). (ORPHA:3376)
- Hypertelorism (HP:0000316): Interpupillary distance more than 2 SD above the mean (alternatively, the appearance of an increased interpupillary distance or widely spaced eyes). Evidence: TAS. Frequency: Very frequent (HP:0040281). (ORPHA:3376)
These phenotypes are associated with the disease Triploidy syndrome (ORPHA:3376).